Phenotypes associated with the disease neurodevelopmental disorder with epilepsy, spasticity, and brain atrophy (OMIM:618741):
- Narrow forehead (HP:0000341): Width of the forehead or distance between the frontotemporales is more than two standard deviations below the mean (objective); or apparently narrow intertemporal region (subjective). Evidence: PCS. (PMID:31794024)
- Microcephaly (HP:0000252): Head circumference below 2 standard deviations below the mean for age and gender. Evidence: PCS. Frequency: 7/7. (PMID:31794024)
- Scoliosis (HP:0002650): The presence of an abnormal lateral curvature of the spine. Evidence: PCS. (PMID:31794024)
- Long philtrum (HP:0000343): Distance between nasal base and midline upper lip vermilion border more than 2 SD above the mean. Alternatively, an apparently increased distance between nasal base and midline upper lip vermilion border. Evidence: PCS. (PMID:31794024)
- Seizure (HP:0001250): A seizure is an intermittent abnormality of nervous system physiology characterized by a transient occurrence of signs and/or symptoms due to abnormal excessive or synchronous neuronal activity in the brain. Evidence: PCS. Frequency: 7/7. (PMID:31794024)
- Cerebellar atrophy (HP:0001272): Cerebellar atrophy is defined as a cerebellum with initially normal structures, in a posterior fossa with normal size, which displays enlarged fissures (interfolial spaces) in comparison to the foliae secondary to loss of tissue. Cerebellar atrophy implies irreversible loss of tissue and result from an ongoing progressive disease until a final stage is reached or a single injury, e.g. an intoxication or infectious event. Evidence: PCS. (PMID:31794024)
- Profound intellectual disability (HP:0002187): Profound intellectual disability (ID) is defined as a type of ID characterized by profoundly sub-average adaptive functioning and intellectual functioning, with an intelligence quotient (IQ) below 20. Evidence: PCS. Frequency: 7/7. (PMID:31794024)
- Global developmental delay (HP:0001263): A delay in the achievement of motor or mental milestones in the domains of development of a child, including motor skills, speech and language, cognitive skills, and social and emotional skills. This term should only be used to describe children younger than five years of age. Evidence: PCS. Frequency: 7/7. (PMID:31794024)
- Spastic tetraparesis (HP:0001285): Spastic weakness affecting all four limbs. Evidence: IEA. (PMID:31794024)
- Brain atrophy (HP:0012444): Partial or complete wasting (loss) of brain tissue that was once present. Evidence: PCS. (PMID:31794024)
- Sensorineural hearing impairment (HP:0000407): A type of hearing impairment in one or both ears related to an abnormal functionality of the cochlear nerve. Evidence: PCS. Frequency: 2/6. (PMID:31794024)
- Autosomal recessive inheritance (HP:0000007): A mode of inheritance that is observed for traits related to a gene encoded on one of the autosomes (i.e., the human chromosomes 1-22) in which a trait manifests in individuals with two pathogenic alleles, either homozygotes (two copies of the same mutant allele) or compound heterozygotes (whereby each copy of a gene has a distinct mutant allele). Evidence: PCS. (PMID:31794024)
- Feeding difficulties in infancy (HP:0008872): Impaired feeding performance of an infant as manifested by difficulties such as weak and ineffective sucking, brief bursts of sucking, and falling asleep during sucking. There may be difficulties with chewing or maintaining attention. Evidence: PCS. Onset: Neonatal onset (HP:0003623). (PMID:31794024)
- Neonatal onset (HP:0003623): Onset of signs or symptoms of disease within the first 28 days of life. Evidence: PCS. Frequency: 7/7. (PMID:31794024)